- Downslanted palpebral fissures (HP:0000494, a Human Phenotype Ontology term): The palpebral fissure inclination is more than two standard deviations below the mean. Evidence: IEA. (OMIM:606851)
- Cleft soft palate (HP:0000185, a Human Phenotype Ontology term): Cleft of the soft palate (also known as the velum, or muscular palate) as a result of a developmental defect occurring between the 7th and 12th week of pregnancy. Cleft soft palate can cause functional abnormalities of the Eustachian tube with resulting middle ear anomalies and hearing difficulties, as well as speech problems associated with hypernasal speech due to velopharyngeal insufficiency. Evidence: IEA. (OMIM:606851)
- Global developmental delay (HP:0001263, a Human Phenotype Ontology term): A delay in the achievement of motor or mental milestones in the domains of development of a child, including motor skills, speech and language, cognitive skills, and social and emotional skills. This term should only be used to describe children younger than five years of age. Evidence: IEA. Frequency: 20/20. (OMIM:606851)
- Cutaneous finger syndactyly (HP:0010554, a Human Phenotype Ontology term): A soft tissue continuity in the A/P axis between two fingers that extends distally to at least the level of the proximal interphalangeal joints, or a soft tissue continuity in the A/P axis between two fingers that lies significantly distal to the flexion crease that overlies the metacarpophalangeal joint of the adjacent fingers. Evidence: TAS. (OMIM:606851)
- Rocker bottom foot (HP:0001838, a Human Phenotype Ontology term): The presence of both a prominent heel and a convex contour of the sole. Evidence: IEA. (OMIM:606851)
- Ptosis (HP:0000508, a Human Phenotype Ontology term): The upper eyelid margin is positioned 3 mm or more lower than usual and covers the superior portion of the iris (objective); or, the upper lid margin obscures at least part of the pupil (subjective). Evidence: IEA. (OMIM:606851)
- Large fontanelles (HP:0000239, a Human Phenotype Ontology term): In newborns, the two frontal bones, two parietal bones, and one occipital bone are joined by fibrous sutures, which form a small posterior fontanelle, and a larger, diamond-shaped anterior fontanelle. These regions allow for the skull to pass the birth canal and for later growth. The fontanelles gradually ossify, whereby the posterior fontanelle usually closes by eight weeks and the anterior fontanelle by the 9th to 16th month of age. Large fontanelles are diagnosed if the fontanelles are larger than age-dependent norms. Evidence: IEA. (OMIM:606851)
- Hypertelorism (HP:0000316, a Human Phenotype Ontology term): Interpupillary distance more than 2 SD above the mean (alternatively, the appearance of an increased interpupillary distance or widely spaced eyes). Evidence: IEA. (OMIM:606851)
- Pectus excavatum (HP:0000767, a Human Phenotype Ontology term): A defect of the chest wall characterized by a depression of the sternum, giving the chest ("pectus") a caved-in ("excavatum") appearance. Evidence: IEA. (OMIM:606851)
- Autosomal recessive inheritance (HP:0000007, a Human Phenotype Ontology term): A mode of inheritance that is observed for traits related to a gene encoded on one of the autosomes (i.e., the human chromosomes 1-22) in which a trait manifests in individuals with two pathogenic alleles, either homozygotes (two copies of the same mutant allele) or compound heterozygotes (whereby each copy of a gene has a distinct mutant allele). Evidence: IEA. (OMIM:606851)
- Bifid scrotum (HP:0000048, a Human Phenotype Ontology term): Midline indentation or cleft of the scrotum. Evidence: IEA. (OMIM:606851)
- Hypospadias (HP:0000047, a Human Phenotype Ontology term): Abnormal position of urethral meatus on the ventral penile shaft (underside) characterized by displacement of the urethral meatus from the tip of the glans penis to the ventral surface of the penis, scrotum, or perineum. Evidence: IEA. (OMIM:606851)
- Webbed neck (HP:0000465, a Human Phenotype Ontology term): Pterygium colli is a congenital skin fold that runs along the sides of the neck down to the shoulders. It involves an ectopic fibrotic facial band superficial to the trapezius muscle. Excess hair-bearing skin is also present and extends down the cervical region well beyond the normal hairline. Evidence: IEA. (OMIM:606851)
- Cryptorchidism (HP:0000028, a Human Phenotype Ontology term): Testis in inguinal canal. That is, absence of one or both testes from the scrotum owing to failure of the testis or testes to descend through the inguinal canal to the scrotum. Evidence: IEA. (OMIM:606851)
- Brachycephaly (HP:0000248, a Human Phenotype Ontology term): An abnormality of skull shape characterized by a decreased anterior-posterior diameter. That is, a cephalic index greater than 81%. Alternatively, an apparently shortened anteroposterior dimension (length) of the head compared to width. Evidence: IEA. (OMIM:606851)
- Triangular face (HP:0000325, a Human Phenotype Ontology term): Facial contour, as viewed from the front, triangular in shape, with breadth at the temples and tapering to a narrow chin. Evidence: IEA. (OMIM:606851)
- Micrognathia (HP:0000347, a Human Phenotype Ontology term): Developmental hypoplasia of the mandible. Evidence: IEA. (OMIM:606851)
- Posteriorly rotated ears (HP:0000358, a Human Phenotype Ontology term): A type of abnormal location of the ears in which the position of the ears is characterized by posterior rotation (the superior part of the ears is rotated towards the back of the head, and the inferior part of the ears towards the front). Evidence: IEA. (OMIM:606851)
- Low-set ears (HP:0000369, a Human Phenotype Ontology term): Upper insertion of the ear to the scalp below an imaginary horizontal line drawn between the inner canthi of the eye and extending posteriorly to the ear. Evidence: IEA. (OMIM:606851)
- Coloboma (HP:0000589, a Human Phenotype Ontology term): A developmental defect characterized by a cleft of some portion of the eye or ocular adnexa. Evidence: IEA. (OMIM:606851)
- Intellectual disability (HP:0001249, a Human Phenotype Ontology term): The term intellectual disability or intellectual developmental disorder is used to describe significantly sub-average intellectual and adaptive functioning based on clinical assessment and as measured by individually administered, appropriately normed, standardized and validated tests of intellectual functioning and adaptive behavior, with onset during the developmental period from infancy through adolescence. Evidence: TAS. (OMIM:606851)
- Aplasia/Hypoplasia of the ribs (HP:0006712, a Human Phenotype Ontology term). Evidence: IEA. (OMIM:606851)
These phenotypes are associated with the disease Cree intellectual disability syndrome (OMIM:606851, an entry in Online Mendelian Inheritance in Man).